Phenotypes associated with the disease Acquired aneurysmal subarachnoid hemorrhage (ORPHA:90065):
- Abnormal cerebral artery morphology (HP:0009145): Any structural anomaly of a cerebral artery. The cerebral arteries comprise three main pairs of arteries and their branches, which supply the cerebrum of the brain. These are the anterior cerebral artery, the middle cerebral artery, and the posterior cerebral artery. Evidence: TAS. Frequency: Very frequent (HP:0040281). (ORPHA:90065)
- Hypertension (HP:0000822): The presence of chronic increased pressure in the systemic arterial system. Evidence: TAS. Frequency: Frequent (HP:0040282). (ORPHA:90065)
- Constriction of peripheral visual field (HP:0001133): An absolute or relative decrease in retinal sensitivity extending from edge (periphery) of the visual field in a concentric pattern. The visual field is the area that is perceived simultaneously by a fixating eye. Evidence: TAS. Frequency: Frequent (HP:0040282). (ORPHA:90065)
- Coma (HP:0001259): The complete absence of wakefulness and consciousness, which is evident through a lack of response to any form of external stimuli. Evidence: TAS. Frequency: Frequent (HP:0040282). (ORPHA:90065)
- Cerebral hemorrhage (HP:0001342): Hemorrhage into the parenchyma of the brain. Evidence: TAS. Frequency: Frequent (HP:0040282). (ORPHA:90065)
- Vomiting (HP:0002013): Forceful ejection of the contents of the stomach through the mouth by means of a series of involuntary spasmic contractions. Evidence: TAS. Frequency: Frequent (HP:0040282). (ORPHA:90065)
- Nausea (HP:0002018): A sensation of unease in the stomach together with an urge to vomit. Evidence: TAS. Frequency: Frequent (HP:0040282). (ORPHA:90065)
- Headache (HP:0002315): Cephalgia, or pain sensed in various parts of the head, not confined to the area of distribution of any nerve. Evidence: TAS. Frequency: Frequent (HP:0040282). (ORPHA:90065)
- Memory impairment (HP:0002354): An impairment of memory as manifested by a reduced ability to remember things such as dates and names, and increased forgetfulness. Evidence: TAS. Frequency: Frequent (HP:0040282). (ORPHA:90065)
- ST segment depression (HP:0012250): An electrocardiographic anomaly in which the ST segment is observed to be located inferior to the isoelectric line. Evidence: TAS. Frequency: Frequent (HP:0040282). (ORPHA:90065)
- Vasospasm (HP:0025637): Narrowing of an artery due to constriction of the blood vessels. Evidence: TAS. Frequency: Frequent (HP:0040282). (ORPHA:90065)
- Cognitive impairment (HP:0100543): Abnormal cognition is characterized by deficits in thinking, reasoning, or remembering. Evidence: TAS. Frequency: Frequent (HP:0040282). (ORPHA:90065)
- Hydrocephalus (HP:0000238): Hydrocephalus is an active distension of the ventricular system of the brain resulting from inadequate passage of CSF from its point of production within the cerebral ventricles to its point of absorption into the systemic circulation. Evidence: TAS. Frequency: Occasional (HP:0040283). (ORPHA:90065)
- Visual impairment (HP:0000505): Visual impairment (or vision impairment) is vision loss (of a person) to such a degree as to qualify as an additional support need through a significant limitation of visual capability resulting from either disease, trauma, or congenital or degenerative conditions that cannot be corrected by conventional means, such as refractive correction, medication, or surgery. Evidence: TAS. Frequency: Occasional (HP:0040283). (ORPHA:90065)
- Hypothyroidism (HP:0000821): Deficiency of thyroid hormone. Evidence: TAS. Frequency: Occasional (HP:0040283). (ORPHA:90065)
- Seizure (HP:0001250): A seizure is an intermittent abnormality of nervous system physiology characterized by a transient occurrence of signs and/or symptoms due to abnormal excessive or synchronous neuronal activity in the brain. Evidence: TAS. Frequency: Occasional (HP:0040283). (ORPHA:90065)
- Syncope (HP:0001279): A transient loss of consciousness (i.e., characterized by a rapid onset, a short duration, and a spontaneous and complete recovery) due to cerebral hypoperfusion. Evidence: TAS. Frequency: Occasional (HP:0040283). (ORPHA:90065)
- Congestive heart failure (HP:0001635): The presence of an abnormality of cardiac function that is responsible for the failure of the heart to pump blood at a rate that is commensurate with the needs of the tissues or a state in which abnormally elevated filling pressures are required for the heart to do so. Heart failure is frequently related to a defect in myocardial contraction. Evidence: TAS. Frequency: Occasional (HP:0040283). (ORPHA:90065)
- Myocardial infarction (HP:0001658): Necrosis of the myocardium caused by an obstruction of the blood supply to the heart and often associated with chest pain, shortness of breath, palpitations, and anxiety as well as characteristic EKG findings and elevation of serum markers including creatine kinase-MB fraction and troponin. Evidence: TAS. Frequency: Occasional (HP:0040283). (ORPHA:90065)
- Left ventricular hypertrophy (HP:0001712): Enlargement or increased size of the heart left ventricle. Evidence: TAS. Frequency: Occasional (HP:0040283). (ORPHA:90065)
- Increased total leukocyte count (HP:0001974): An abnormal increase in the number of leukocytes in the blood. Evidence: TAS. Frequency: Occasional (HP:0040283). (ORPHA:90065)
- Ischemic stroke (HP:0002140): Acute ischemic stroke (AIS) is defined by the sudden loss of blood flow to an area of the brain with the resulting loss of neurologic function. It is caused by thrombosis or embolism that occludes a cerebral vessel supplying a specific area of the brain. During a vessel occlusion, there is a core area where damage to the brain is irreversible and an area of penumbra where the brain has lost function owing to decreased blood flow but is not irreversibly injured. Evidence: TAS. Frequency: Occasional (HP:0040283). (ORPHA:90065)
- Progressive neurologic deterioration (HP:0002344). Evidence: TAS. Frequency: Occasional (HP:0040283). (ORPHA:90065)
- Increased CSF lactate (HP:0002490): Increased concentration of lactate in the cerebrospinal fluid. Evidence: TAS. Frequency: Occasional (HP:0040283). (ORPHA:90065)
- Cerebral ischemia (HP:0002637): Restriction of arterial blood supply to the brain associated with insufficient oxygenation to support the metabolic requirements of the tissue. Evidence: TAS. Frequency: Occasional (HP:0040283). (ORPHA:90065)
- Hyperglycemia (HP:0003074): An increased concentration of glucose in the blood. Evidence: TAS. Frequency: Occasional (HP:0040283). (ORPHA:90065)
- Hypercholesterolemia (HP:0003124): An increased concentration of cholesterol in the blood. Evidence: TAS. Frequency: Occasional (HP:0040283). (ORPHA:90065)
- Functional motor deficit (HP:0004302). Evidence: TAS. Frequency: Occasional (HP:0040283). (ORPHA:90065)
- Prolonged QTc interval (HP:0005184): A longer than normal interval (corrected for heart rate) between the Q and T waves in the heart's cycle. Prolonged QTc can cause premature action potentials during late phase depolarizations thereby leading to ventricular arrhythmias and ventricular fibrillations. Evidence: TAS. Frequency: Occasional (HP:0040283). (ORPHA:90065)
- Cranial nerve paralysis (HP:0006824). Evidence: TAS. Frequency: Occasional (HP:0040283). (ORPHA:90065)
- Addictive alcohol use (HP:0030955): An addictive behavior is defined as drinking excessive amounts of alcohol over a prolonged period of time, having difficulty in reducing the amount of alcohol consumed, strongly desiring alcohol, and experiencing withdrawal symptoms when not drinking alcohol. Evidence: TAS. Frequency: Occasional (HP:0040283). (ORPHA:90065)
- Impairment of activities of daily living (HP:0031058): Difficulty in performing one or more activities normally performed every day, such as eating, bathing, dressing, grooming, work, homemaking, and leisure. Evidence: TAS. Frequency: Occasional (HP:0040283). (ORPHA:90065)
- Hyperglycorrhachia (HP:0031885): Abnormally high glucose concentration in the cerebrospinal fluid. Evidence: TAS. Frequency: Occasional (HP:0040283). (ORPHA:90065)
- Hypopituitarism (HP:0040075). Evidence: TAS. Frequency: Very rare (HP:0040284). (ORPHA:90065)